Phenotypes associated with the disease Thymic neuroendocrine tumor (ORPHA:97289):
- Neoplasm of the thymus (HP:0100521): A tumor (abnormal growth of tissue) of the thymus. Evidence: TAS. Frequency: Obligate (HP:0040280). (ORPHA:97289)
- Neuroendocrine neoplasm (HP:0100634): A tumor that originates from a neuroendocrine cell. Evidence: TAS. Frequency: Obligate (HP:0040280). (ORPHA:97289)
- Abnormal mediastinum morphology (HP:0045026): Any structural anomaly of the central compartment of the thoracic cavity. Evidence: TAS. Frequency: Very frequent (HP:0040281). (ORPHA:97289)
- Mediastinal lymphadenopathy (HP:0100721): Swelling of lymph nodes within the mediastinum, the central compartment of the thoracic cavities that contains the heart and the great vessels, the esophagus, and trachea and other structures including lymph nodes. Evidence: TAS. Frequency: Very frequent (HP:0040281). (ORPHA:97289)
- Weight loss (HP:0001824): Reduction of total body weight. Evidence: TAS. Frequency: Frequent (HP:0040282). (ORPHA:97289)
- Chronic noninfectious lymphadenopathy (HP:0002730): A chronic form of lymphadenopathy that is not related to infection. Evidence: TAS. Frequency: Frequent (HP:0040282). (ORPHA:97289)
- Increased circulating cortisol level (HP:0003118): Overproduction of the hormone of cortisol by the adrenal cortex, resulting in a characteristic combination of clinical symptoms termed Cushing syndrome, with truncal obesity, a round, full face, striae atrophicae and acne, muscle weakness, and other features. Evidence: TAS. Frequency: Frequent (HP:0040282). (ORPHA:97289)
- Increased circulating ACTH level (HP:0003154): An abnormal increased in the concentration of corticotropin, also known as adrenocorticotropic hormone (ACTH), in the blood. Evidence: TAS. Frequency: Frequent (HP:0040282). (ORPHA:97289)
- Abnormal vena cava morphology (HP:0005345): An abnormality of the structure of the veins that return deoxygenated blood from the body into the heart, i.e., the superior vena cava and the inferior vena cava. Evidence: TAS. Frequency: Frequent (HP:0040282). (ORPHA:97289)
- Prominent veins on trunk (HP:0007457): Prominent thoracic and abdominal veins. Evidence: TAS. Frequency: Frequent (HP:0040282). (ORPHA:97289)
- Cough (HP:0012735): A sudden, audible expulsion of air from the lungs through a partially closed glottis, preceded by inhalation. Evidence: TAS. Frequency: Frequent (HP:0040282). (ORPHA:97289)
- Abnormal breath sound (HP:0030829): An anomalous (adventitious) sound produced by the breathing process. Evidence: TAS. Frequency: Frequent (HP:0040282). (ORPHA:97289)
- Neoplasm of the endocrine system (HP:0100568): A tumor (abnormal growth of tissue) of the endocrine system. Evidence: TAS. Frequency: Frequent (HP:0040282). (ORPHA:97289)
- Carcinoid tumor (HP:0100570): A tumor formed from the endocrine (argentaffin) cells of the mucosal lining of a variety of organs including the stomach and intestine. These cells are from neuroectodermal origin. Evidence: TAS. Frequency: Frequent (HP:0040282). (ORPHA:97289)
- Chest pain (HP:0100749): An unpleasant sensation characterized by physical discomfort (such as pricking, throbbing, or aching) localized to the chest. Evidence: TAS. Frequency: Frequent (HP:0040282). (ORPHA:97289)
- Increased circulating prolactin concentration (HP:0000870): The presence of abnormally increased levels of prolactin in the blood. Prolactin is a peptide hormone produced by the anterior pituitary gland that plays a role in breast development and lactation during pregnancy. Evidence: TAS. Frequency: Occasional (HP:0040283). (ORPHA:97289)
- Osteopenia (HP:0000938): Osteopenia is a term to define bone density that is not normal but also not as low as osteoporosis. By definition from the World Health Organization osteopenia is defined by bone densitometry as a T score -1 to -2.5. Evidence: TAS. Frequency: Occasional (HP:0040283). (ORPHA:97289)
- Pituitary adenoma (HP:0002893): A benign epithelial tumor derived from intrinsic cells of the adenohypophysis (anterior pituitary). Evidence: TAS. Frequency: Occasional (HP:0040283). (ORPHA:97289)
- Hypercalcemia (HP:0003072): The concentration of calcium in the blood circulation is above the upper limit of normal. Evidence: TAS. Frequency: Occasional (HP:0040283). (ORPHA:97289)
- Calcium nephrolithiasis (HP:0004724): The presence of calcium-containing calculi (stones) in the kidneys. Evidence: TAS. Frequency: Occasional (HP:0040283). (ORPHA:97289)
- Pituitary prolactin cell adenoma (HP:0006767): A type of pituitary adenoma originating in prolactin secreting cells. This kind of adenoma is characterized by overproduction of prolactin, and may cause loss of menstrual periods and breast milk production in women. Evidence: TAS. Frequency: Occasional (HP:0040283). (ORPHA:97289)
- Primary hyperparathyroidism (HP:0008200): A type of hyperparathyroidism caused by a primary abnormality of the parathyroid glands (e.g., adenoma, carcinoma, hyperplasia). Primary hyperparathyroidism is associated with hyercalcemia. Evidence: TAS. Frequency: Occasional (HP:0040283). (ORPHA:97289)
- Pancreatic islet cell adenoma (HP:0008261): The presence of an adenoma of the pancreas with origin in a pancreatic B cell. Evidence: TAS. Frequency: Occasional (HP:0040283). (ORPHA:97289)
- Pituitary null cell adenoma (HP:0011761): A type of pituitary adenoma that is of unknown cellular origin and that lacks immunocytochemical or fine structural markers. Null cell adenomas are not associated with hormone excess. Evidence: TAS. Frequency: Occasional (HP:0040283). (ORPHA:97289)